Phenotypes associated with the disease Thiemann disease, familial form (ORPHA:3314):
- Abnormal metaphysis morphology (HP:0000944): An abnormality of one or more metaphysis, i.e., of the somewhat wider portion of a long bone that is adjacent to the epiphyseal growth plate and grows during childhood. Evidence: TAS. Frequency: Occasional (HP:0040283). (ORPHA:3314)
- Brachydactyly (HP:0001156): Digits that appear disproportionately short compared to the hand/foot. The word brachydactyly is used here to describe a series distinct patterns of shortened digits (brachydactyly types A-E). This is the sense used here. Evidence: TAS. Frequency: Frequent (HP:0040282). (ORPHA:3314)
- Limitation of joint mobility (HP:0001376): A reduction in the freedom of movement of one or more joints. Evidence: TAS. Frequency: Frequent (HP:0040282). (ORPHA:3314)
- Abnormal epiphysis morphology (HP:0005930): An anomaly of epiphysis, which is the expanded articular end of a long bone that developes from a secondary ossification center, and which during the period of growth is either entirely cartilaginous or is separated from the shaft by a cartilaginous disk. Evidence: TAS. Frequency: Very frequent (HP:0040281). (ORPHA:3314)
- Avascular necrosis (HP:0010885): A disease where there is cellular death (necrosis) of bone components due to interruption of the blood supply. Evidence: TAS. Frequency: Very frequent (HP:0040281). (ORPHA:3314)